- Hand monodactyly (HP:0004058). Evidence: TAS. Frequency: Very frequent (HP:0040281). (ORPHA:1986)
- Aplasia/Hypoplasia of the tibia (HP:0005772): Absence or underdevelopment of the tibia. Evidence: TAS. Frequency: Very frequent (HP:0040281). (ORPHA:1986)
- Aplasia/Hypoplasia of the ulna (HP:0006495): Absence or underdevelopment of the ulna. Evidence: TAS. Frequency: Frequent (HP:0040282). (ORPHA:1986)
- Bifid femur (HP:0010443): A bifid or bifurcated appearance of the femur as seen on x-rays, possible appearing as a more or less severe bowing of the upper leg. Might be associated with hip dysplasia on the affected side. Evidence: TAS. Frequency: Very frequent (HP:0040281). (ORPHA:1986)
- Ectrodactyly (HP:0100257): A condition in which middle parts of the hands and/or feet (digits and meta-carpals and -tarsals) are missing giving a cleft appearance. The severity is very variable ranging from slightly hypoplastic 3rd toe/fingers over absent 2nd or 3rd toes/fingers as far as oligo- or monodactyl hands and/or feet. Evidence: TAS. Frequency: Very frequent (HP:0040281). (ORPHA:1986)
These phenotypes are associated with the disease Gollop-Wolfgang complex (ORPHA:1986).